- Sensorineural hearing impairment (HP:0000407): A type of hearing impairment in one or both ears related to an abnormal functionality of the cochlear nerve. Evidence: TAS. Frequency: Frequent (HP:0040282). (ORPHA:66633)
- Blue sclerae (HP:0000592): An abnormal bluish coloration of the sclera. Evidence: TAS. Frequency: Very frequent (HP:0040281). (ORPHA:66633)
- Heterochromia iridis (HP:0001100): Heterochromia iridis is a difference in the color of the iris in the two eyes. Evidence: TAS. Frequency: Occasional (HP:0040283). (ORPHA:66633)
- Tremor (HP:0001337): An unintentional, oscillating to-and-fro muscle movement about a joint axis. Evidence: TAS. Frequency: Frequent (HP:0040282). (ORPHA:66633)
- Premature graying of hair (HP:0002216): Development of gray hair at a younger than normal age. Evidence: TAS. Frequency: Very frequent (HP:0040281). (ORPHA:66633)
These phenotypes are associated with the disease Sensorineural hearing loss-early graying-essential tremor syndrome (ORPHA:66633).